Phenotypes associated with the disease intellectual disability, autosomal recessive 59 (OMIM:617323):
- Aggressive behavior (HP:0000718): Behavior or an act aimed at harming a person, animal, or physical property (e.g., acts of physical violence; shouting, swearing, and using harsh language; slashing someone's tires). Evidence: PCS. Frequency: 6/9. (PMID:26416544)
- Autosomal recessive inheritance (HP:0000007): A mode of inheritance that is observed for traits related to a gene encoded on one of the autosomes (i.e., the human chromosomes 1-22) in which a trait manifests in individuals with two pathogenic alleles, either homozygotes (two copies of the same mutant allele) or compound heterozygotes (whereby each copy of a gene has a distinct mutant allele). Evidence: PCS. (PMID:26416544)
- Paranoia (HP:0011999): The feeling and belief that one is being targeted or is a focus of negative or untoward actions, overt or covert, from others. The affected individual expresses a concern that people are in general against the individual and are engaging in subtle behaviors to make things difficult for them. The origins of such thinking may arise from real events and become amplified over time. Paranoia may also arise in the absence of any action or interaction between the person and their environment. Evidence: PCS. Frequency: 6/9. (PMID:26416544)
- Intellectual disability (HP:0001249): The term intellectual disability or intellectual developmental disorder is used to describe significantly sub-average intellectual and adaptive functioning based on clinical assessment and as measured by individually administered, appropriately normed, standardized and validated tests of intellectual functioning and adaptive behavior, with onset during the developmental period from infancy through adolescence. Evidence: PCS. Frequency: 9/9. (PMID:26416544)